- Multicystic kidney dysplasia (HP:0000003): Multicystic dysplasia of the kidney is characterized by multiple cysts of varying size in the kidney and the absence of a normal pelvicaliceal system. The condition is associated with ureteral or ureteropelvic atresia, and the affected kidney is nonfunctional. Evidence: TAS. Frequency: Very frequent (HP:0040281). (ORPHA:261265)
- Cryptorchidism (HP:0000028): Testis in inguinal canal. That is, absence of one or both testes from the scrotum owing to failure of the testis or testes to descend through the inguinal canal to the scrotum. Evidence: TAS. Frequency: Occasional (HP:0040283). (ORPHA:261265)
- Shawl scrotum (HP:0000049): Superior margin of the scrotum superior to the base of the penis. Evidence: TAS. Frequency: Occasional (HP:0040283). (ORPHA:261265)
- Ureterocele (HP:0000070): A ureterocele is a congenital saccular dilatation of the distal segment of the ureter. Evidence: TAS. Frequency: Occasional (HP:0040283). (ORPHA:261265)
- Renal insufficiency (HP:0000083): A reduction in the level of performance of the kidneys in areas of function comprising the concentration of urine, removal of wastes, the maintenance of electrolyte balance, homeostasis of blood pressure, and calcium metabolism. Evidence: TAS. Frequency: Occasional (HP:0040283). (ORPHA:261265)
- Large fontanelles (HP:0000239): In newborns, the two frontal bones, two parietal bones, and one occipital bone are joined by fibrous sutures, which form a small posterior fontanelle, and a larger, diamond-shaped anterior fontanelle. These regions allow for the skull to pass the birth canal and for later growth. The fontanelles gradually ossify, whereby the posterior fontanelle usually closes by eight weeks and the anterior fontanelle by the 9th to 16th month of age. Large fontanelles are diagnosed if the fontanelles are larger than age-dependent norms. Evidence: TAS. Frequency: Occasional (HP:0040283). (ORPHA:261265)
- Hearing impairment (HP:0000365): A decreased magnitude of the sensory perception of sound. Evidence: TAS. Frequency: Occasional (HP:0040283). (ORPHA:261265)
- Autism (HP:0000717): Autism is a neurodevelopmental disorder characterized by impaired social interaction and communication, and by restricted and repetitive behavior. Autism begins in childhood. It is marked by the presence of markedly abnormal or impaired development in social interaction and communication and a markedly restricted repertoire of activity and interest. Manifestations of the disorder vary greatly depending on the developmental level and chronological age of the individual (DSM-IV). Evidence: TAS. Frequency: Occasional (HP:0040283). (ORPHA:261265)
- Diabetes mellitus (HP:0000819): A group of abnormalities characterized by hyperglycemia and glucose intolerance. Evidence: TAS. Frequency: Frequent (HP:0040282). (ORPHA:261265)
- Intellectual disability (HP:0001249): The term intellectual disability or intellectual developmental disorder is used to describe significantly sub-average intellectual and adaptive functioning based on clinical assessment and as measured by individually administered, appropriately normed, standardized and validated tests of intellectual functioning and adaptive behavior, with onset during the developmental period from infancy through adolescence. Evidence: TAS. Frequency: Occasional (HP:0040283). (ORPHA:261265)
- Seizure (HP:0001250): A seizure is an intermittent abnormality of nervous system physiology characterized by a transient occurrence of signs and/or symptoms due to abnormal excessive or synchronous neuronal activity in the brain. Evidence: TAS. Frequency: Occasional (HP:0040283). (ORPHA:261265)
- Global developmental delay (HP:0001263): A delay in the achievement of motor or mental milestones in the domains of development of a child, including motor skills, speech and language, cognitive skills, and social and emotional skills. This term should only be used to describe children younger than five years of age. Evidence: TAS. Frequency: Occasional (HP:0040283). (ORPHA:261265)
- Oligohydramnios (HP:0001562): Diminished amniotic fluid volume in pregnancy. Evidence: TAS. Frequency: Occasional (HP:0040283). (ORPHA:261265)
- Cerebral atrophy (HP:0002059): Atrophy (wasting, decrease in size of cells or tissue) affecting the cerebrum. Evidence: TAS. Frequency: Occasional (HP:0040283). (ORPHA:261265)
- Language impairment (HP:0002463): Language impairment is a deficit in comprehension or production of language that includes reduced vocabulary, limited sentence structure, or impairments in written or spoken communication. Language abilities are substantially and quantifiably below age expectations. Evidence: TAS. Frequency: Occasional (HP:0040283). (ORPHA:261265)
- Elevated circulating hepatic transaminase concentration (HP:0002910): Elevations of the levels of SGOT and SGPT in the serum. SGOT (serum glutamic oxaloacetic transaminase) and SGPT (serum glutamic pyruvic transaminase) are transaminases primarily found in the liver and heart and are released into the bloodstream as the result of liver or heart damage. SGOT and SGPT are used clinically mainly as markers of liver damage. Evidence: TAS. Frequency: Occasional (HP:0040283). (ORPHA:261265)
- Short stature (HP:0004322): A height below that which is expected according to age and gender norms. Although there is no universally accepted definition of short stature, many refer to "short stature" as height more than 2 standard deviations below the mean for age and gender (or below the 3rd percentile for age and gender dependent norms). Evidence: TAS. Frequency: Frequent (HP:0040282). (ORPHA:261265)
- Renal hypoplasia/aplasia (HP:0008678): Absence or underdevelopment of the kidney. Evidence: TAS. Frequency: Occasional (HP:0040283). (ORPHA:261265)
- Feeding difficulties (HP:0011968): Impaired ability to eat related to problems gathering food and getting ready to suck, chew, or swallow it. Evidence: TAS. Frequency: Occasional (HP:0040283). (ORPHA:261265)
- Subcortical cerebral atrophy (HP:0012157): Atrophy of the cerebral subcortical white and gray matter, termed subcortical atrophy, reflects loss of nerve cells in the basal ganglia or fibers in the deep white matter. Evidence: TAS. Frequency: Occasional (HP:0040283). (ORPHA:261265)
- Pancreatic aplasia (HP:0100801): Aplasia of the pancreas. Evidence: TAS. Frequency: Occasional (HP:0040283). (ORPHA:261265)
These phenotypes are associated with the disease 17q12 microdeletion syndrome (ORPHA:261265).